Phenotypes associated with the disease intellectual disability, X-linked 88 (OMIM:300852):
- Seizure (HP:0001250): A seizure is an intermittent abnormality of nervous system physiology characterized by a transient occurrence of signs and/or symptoms due to abnormal excessive or synchronous neuronal activity in the brain. Evidence: TAS. Frequency: 5/9. (OMIM:300852)
- Global developmental delay (HP:0001263): A delay in the achievement of motor or mental milestones in the domains of development of a child, including motor skills, speech and language, cognitive skills, and social and emotional skills. This term should only be used to describe children younger than five years of age. Evidence: TAS. (OMIM:300852)
- Autism (HP:0000717): Autism is a neurodevelopmental disorder characterized by impaired social interaction and communication, and by restricted and repetitive behavior. Autism begins in childhood. It is marked by the presence of markedly abnormal or impaired development in social interaction and communication and a markedly restricted repertoire of activity and interest. Manifestations of the disorder vary greatly depending on the developmental level and chronological age of the individual (DSM-IV). Evidence: TAS. Frequency: 2/9. (OMIM:300852)
- X-linked inheritance (HP:0001417): A mode of inheritance that is observed for traits related to a gene encoded on the X chromosome. Evidence: TAS. (OMIM:300852)
- Intellectual disability (HP:0001249): The term intellectual disability or intellectual developmental disorder is used to describe significantly sub-average intellectual and adaptive functioning based on clinical assessment and as measured by individually administered, appropriately normed, standardized and validated tests of intellectual functioning and adaptive behavior, with onset during the developmental period from infancy through adolescence. Evidence: TAS. (OMIM:300852)